- Arthralgia (HP:0002829): Joint pain. Evidence: TAS. Frequency: Frequent (HP:0040282). (ORPHA:3408)
- Arthralgia of the hip (HP:0003365): Joint pain affecting the hip. Evidence: TAS. Frequency: Frequent (HP:0040282). (ORPHA:3408)
- Flat capital femoral epiphysis (HP:0003370): An abnormal flattening of the proximal epiphysis of the femur. Evidence: TAS. Frequency: Frequent (HP:0040282). (ORPHA:3408)
- Broad femoral neck (HP:0006429): An abnormally wide femoral neck (which is the process of bone, connecting the femoral head with the femoral shaft). Evidence: TAS. Frequency: Frequent (HP:0040282). (ORPHA:3408)
- Premature epimetaphyseal fusion (HP:0010588): Stop of growth at the epiphyseal plate the hyaline cartilage plate in the metaphysis at each end of a long bone, at an earlier than normal age, resulting in growth arrest and shortening of the involved bone. Evidence: TAS. Frequency: Frequent (HP:0040282). (ORPHA:3408)
- Enchondroma (HP:0030038): A solitary, benign, intramedullary cartilage tumor that is often found in the short tubular bones of the hands and feet, distal femur, and proximal humerus. Evidence: TAS. Frequency: Frequent (HP:0040282). (ORPHA:3408)
These phenotypes are associated with the disease Upington disease (ORPHA:3408).